- Abnormality of the ovary (HP:0000137): An abnormality of the ovary. Evidence: TAS. Frequency: Very frequent (HP:0040281). (ORPHA:314478)
- Hirsutism (HP:0001007): Abnormally increased hair growth referring to a male pattern of body hair (androgenic hair). Evidence: TAS. Frequency: Occasional (HP:0040283). (ORPHA:314478)
- Ascites (HP:0001541): Accumulation of fluid in the peritoneal cavity (between the layers of the peritoneum that lines the abdomen). Evidence: TAS. Frequency: Frequent (HP:0040282). (ORPHA:314478)
- Abdominal pain (HP:0002027): An unpleasant sensation characterized by physical discomfort (such as pricking, throbbing, or aching) and perceived to originate in the abdomen. Evidence: TAS. Frequency: Very frequent (HP:0040281). (ORPHA:314478)
- Pleural effusion (HP:0002202): The presence of an excessive amount of fluid in the pleural cavity. Evidence: TAS. Frequency: Very frequent (HP:0040281). (ORPHA:314478)
- Peritonitis (HP:0002586): Inflammation of the peritoneum. Evidence: TAS. Frequency: Frequent (HP:0040282). (ORPHA:314478)
- Abnormal circulating hormone concentration (HP:0003117): Concentration of a hormone in the blood circulation outside of normal limits. Evidence: TAS. Frequency: Occasional (HP:0040283). (ORPHA:314478)
- Abdominal distention (HP:0003270): Distention of the abdomen. Evidence: TAS. Frequency: Very frequent (HP:0040281). (ORPHA:314478)
- Diffuse leiomyomatosis (HP:0006756). Evidence: TAS. Frequency: Occasional (HP:0040283). (ORPHA:314478)
- Gonadal calcification (HP:0008703): Deposition of calcium salts in gonadal tissue. Evidence: TAS. Frequency: Occasional (HP:0040283). (ORPHA:314478)
- Ovarian fibroma (HP:0010618): The presence of a fibroma of the ovary. Evidence: TAS. Frequency: Very frequent (HP:0040281). (ORPHA:314478)
- Increased serum testosterone level (HP:0030088): An elevated circulating testosterone level in the blood. Evidence: TAS. Frequency: Occasional (HP:0040283). (ORPHA:314478)
- Abnormal endometrium morphology (HP:0030126): An anomaly of the inner mucous membrane of the uterus. Evidence: TAS. Frequency: Occasional (HP:0040283). (ORPHA:314478)
- Fibrosarcoma (HP:0100244): A fibroblastic sarcoma is a malignant tumor derived from fibrous connective tissue and characterized by immature proliferating fibroblasts or undifferentiated anaplastic spindle cells. Evidence: TAS. Frequency: Occasional (HP:0040283). (ORPHA:314478)
- Metrorrhagia (HP:0100608): Bleeding at irregular intervals. Evidence: TAS. Frequency: Very frequent (HP:0040281). (ORPHA:314478)
These phenotypes are associated with the disease Ovarian fibrothecoma (ORPHA:314478).